Phenotypes associated with the disease lichen planus, familial (OMIM:151620):
- Autosomal dominant inheritance (HP:0000006): A mode of inheritance that is observed for traits related to a gene encoded on one of the autosomes (i.e., the human chromosomes 1-22) in which a trait manifests in heterozygotes. In the context of medical genetics, an autosomal dominant disorder is caused when a single copy of the mutant allele is present. Males and females are affected equally, and can both transmit the disorder with a risk of 50% for each child of inheriting the mutant allele. Evidence: IEA. (OMIM:151620)
- Abnormality of the skin (HP:0000951): An abnormality of the skin. Evidence: IEA. (OMIM:151620)